- Impulsivity (HP:0100710): Acting on the spur of the moment or on a momentary basis without consideration of outcomes; having difficulty establishing or following plans; experiencing a sense of urgency and engaging in behavior that is uninhibited, cannot be inhibited, and is uncontrolled. The possibility of repression is inconceivable. Evidence: TAS. (OMIM:300830)
- X-linked recessive inheritance (HP:0001419): A mode of inheritance that is observed for recessive traits related to a gene encoded on the X chromosome. In the context of medical genetics, X-linked recessive disorders manifest in males (who have one copy of the X chromosome and are thus hemizygotes), but generally not in female heterozygotes who have one mutant and one normal allele. Evidence: TAS. (OMIM:300830)
- Hypotonia (HP:0001252): Hypotonia is an abnormally low muscle tone (the amount of tension or resistance to movement in a muscle). Even when relaxed, muscles have a continuous and passive partial contraction which provides some resistance to passive stretching. Hypotonia thus manifests as diminished resistance to passive stretching. Hypotonia is not the same as muscle weakness, although the two conditions can co-exist. Evidence: TAS. Frequency: Occasional (HP:0040283). (OMIM:300830)
- Aggressive behavior (HP:0000718): Behavior or an act aimed at harming a person, animal, or physical property (e.g., acts of physical violence; shouting, swearing, and using harsh language; slashing someone's tires). Evidence: TAS. (OMIM:300830)
- Autism (HP:0000717): Autism is a neurodevelopmental disorder characterized by impaired social interaction and communication, and by restricted and repetitive behavior. Autism begins in childhood. It is marked by the presence of markedly abnormal or impaired development in social interaction and communication and a markedly restricted repertoire of activity and interest. Manifestations of the disorder vary greatly depending on the developmental level and chronological age of the individual (DSM-IV). Evidence: TAS. Frequency: Obligate (HP:0040280). (OMIM:300830)
- Infantile onset (HP:0003593): Onset of signs or symptoms of disease between 28 days to one year of life. Evidence: TAS. (OMIM:300830)
- Generalized hypotonia (HP:0001290): Generalized muscular hypotonia (abnormally low muscle tone). Evidence: TAS. Frequency: Occasional (HP:0040283). (OMIM:300830)
- Attention deficit hyperactivity disorder (HP:0007018): Attention deficit hyperactivity disorder (ADHD) manifests at age 2-3 years or by first grade at the latest. The main symptoms are distractibility, impulsivity, hyperactivity, and often trouble organizing tasks and projects, difficulty going to sleep, and social problems from being aggressive, loud, or impatient. Evidence: TAS. (OMIM:300830)
- Intellectual disability (HP:0001249): The term intellectual disability or intellectual developmental disorder is used to describe significantly sub-average intellectual and adaptive functioning based on clinical assessment and as measured by individually administered, appropriately normed, standardized and validated tests of intellectual functioning and adaptive behavior, with onset during the developmental period from infancy through adolescence. Evidence: TAS. (OMIM:300830)
- Motor tics (HP:0100034): Movement-based tics affecting discrete muscle groups. Evidence: TAS. (OMIM:300830)
These phenotypes are associated with the disease autism, susceptibility to, X-linked 4 (OMIM:300830).